Phenotypes associated with the disease spermatogenic failure 20 (OMIM:617593):
- Coiled sperm flagella (HP:0032560): Sperm cells whose flagella are twisted (coiled). Evidence: PCS. Frequency: 1/1. (PMID:28552195)
- Male infertility (HP:0003251). Evidence: PCS. Frequency: 1/1. (PMID:28552195)
- Young adult onset (HP:0011462): Onset of disease at the age of between 16 and 40 years. Evidence: PCS. Frequency: 1/1. (PMID:28552195)
- Autosomal recessive inheritance (HP:0000007): A mode of inheritance that is observed for traits related to a gene encoded on one of the autosomes (i.e., the human chromosomes 1-22) in which a trait manifests in individuals with two pathogenic alleles, either homozygotes (two copies of the same mutant allele) or compound heterozygotes (whereby each copy of a gene has a distinct mutant allele). Evidence: PCS. (PMID:28552195)
- Absent sperm flagella (HP:0032558): Sperm cells lacking flagella. Evidence: PCS. Frequency: 1/1. (PMID:28552195)
- Short sperm flagella (HP:0032559): Sperm cells with abnormally short flagella. Evidence: PCS. Frequency: 1/1. (PMID:28552195)